Phenotypes associated with the disease cataract 2, multiple types (OMIM:604307):
- Aculeiform cataract (HP:0010926): A kind of nuclear cataract characterized by fiberglasslike or needlelike crystals projecting in different directions, through or close to the axial region of the lens. Evidence: PCS. (PMID:10521291)
- Nuclear cataract (HP:0100018): A nuclear cataract is an opacity or clouding that develops in the lens nucleus. That is, a nuclear cataract is one that is located in the center of the lens. The nucleus tends to darken changing from clear to yellow and sometimes brown. Evidence: TAS. (OMIM:604307)
- Nystagmus (HP:0000639): Rhythmic, involuntary oscillations of one or both eyes related to abnormality in fixation, conjugate gaze, or vestibular mechanisms. Evidence: TAS. (OMIM:604307)
- Microcornea (HP:0000482): A congenital abnormality of the cornea in which the cornea and the anterior segment of the eye are smaller than normal. The horizontal diameter of the cornea does not reach 10 mm even in adulthood. Evidence: TAS. Frequency: Occasional (HP:0040283). (OMIM:604307)
- Developmental cataract (HP:0000519): A cataract that occurs congenitally as the result of a developmental defect, in contrast to the majority of cataracts that occur in adulthood as the result of degenerative changes of the lens. Evidence: IEA. (OMIM:604307)
- Amblyopia (HP:0000646): Reduced visual acuity that is uncorrectable by lenses in the absence of detectable anatomic defects in the eye or visual pathways. Evidence: TAS. (OMIM:604307)
- Photophobia (HP:0000613): Excessive sensitivity to light with the sensation of discomfort or pain in the eyes due to exposure to bright light. Evidence: TAS. Frequency: Occasional (HP:0040283). (OMIM:604307)
- Nuclear pulverulent cataract (HP:0010698): A type of nuclear cataract involving congenital dust-like (pulverulent) opacity of the embryonal and fetal nucleus. Evidence: PCS. (PMID:10521291)
- Visual impairment (HP:0000505): Visual impairment (or vision impairment) is vision loss (of a person) to such a degree as to qualify as an additional support need through a significant limitation of visual capability resulting from either disease, trauma, or congenital or degenerative conditions that cannot be corrected by conventional means, such as refractive correction, medication, or surgery. Evidence: TAS. (OMIM:604307)
- Autosomal dominant inheritance (HP:0000006): A mode of inheritance that is observed for traits related to a gene encoded on one of the autosomes (i.e., the human chromosomes 1-22) in which a trait manifests in heterozygotes. In the context of medical genetics, an autosomal dominant disorder is caused when a single copy of the mutant allele is present. Males and females are affected equally, and can both transmit the disorder with a risk of 50% for each child of inheriting the mutant allele. Evidence: PCS. (PMID:10521291)